Phenotypes associated with the disease VIPoma (ORPHA:97282):
- Neoplasm of the pancreas (HP:0002894): A tumor (abnormal growth of tissue) of the pancreas. Evidence: TAS. Frequency: Very frequent (HP:0040281). (ORPHA:97282)
- Hypokalemia (HP:0002900): The concentration of potassium(1+) in the blood circulation is below the lower limit of normal. Evidence: TAS. Frequency: Very frequent (HP:0040281). (ORPHA:97282)
- Secretory diarrhea (HP:0005208): Watery voluminous diarrhea resulting from an imbalance between ion and water secretion and absorption. Evidence: TAS. Frequency: Very frequent (HP:0040281). (ORPHA:97282)
- Diabetes mellitus (HP:0000819): A group of abnormalities characterized by hyperglycemia and glucose intolerance. Evidence: TAS. Frequency: Frequent (HP:0040282). (ORPHA:97282)
- Weight loss (HP:0001824): Reduction of total body weight. Evidence: TAS. Frequency: Frequent (HP:0040282). (ORPHA:97282)
- Normochromic anemia (HP:0001895). Evidence: TAS. Frequency: Frequent (HP:0040282). (ORPHA:97282)
- Dehydration (HP:0001944). Evidence: TAS. Frequency: Frequent (HP:0040282). (ORPHA:97282)
- Nausea and vomiting (HP:0002017): Nausea is a commonly encountered symptom that has been defined as an unpleasant painless subjective feeling that one will imminently vomit. Vomiting has been defined as the forceful expulsion of the contents of the stomach, duodenum, or jejunum through the oral cavity. While nausea and vomiting are often thought to exist on a temporal continuum, this is not always the case. There are situations when severe nausea may be present without emesis and less frequently, when emesis may be present without preceding nausea. Evidence: TAS. Frequency: Frequent (HP:0040282). (ORPHA:97282)
- Malabsorption (HP:0002024): Impaired ability to absorb one or more nutrients from the intestine. Evidence: TAS. Frequency: Frequent (HP:0040282). (ORPHA:97282)
- Anorexia (HP:0002039): Lack of desire to eat (loss of appetite). Evidence: TAS. Frequency: Frequent (HP:0040282). (ORPHA:97282)
- Hepatomegaly (HP:0002240): Abnormally increased size of the liver. Evidence: TAS. Frequency: Frequent (HP:0040282). (ORPHA:97282)
- Episodic abdominal pain (HP:0002574): An intermittent form of abdominal pain. Evidence: TAS. Frequency: Frequent (HP:0040282). (ORPHA:97282)
- Hypercalcemia (HP:0003072): The concentration of calcium in the blood circulation is above the upper limit of normal. Evidence: TAS. Frequency: Frequent (HP:0040282). (ORPHA:97282)
- Generalized muscle weakness (HP:0003324): Generalized weakness or decreased strength of the muscles, affecting both distal and proximal musculature. Evidence: TAS. Frequency: Frequent (HP:0040282). (ORPHA:97282)
- Muscle spasm (HP:0003394): Sudden and involuntary contractions of one or more muscles. Evidence: TAS. Frequency: Frequent (HP:0040282). (ORPHA:97282)
- Poor appetite (HP:0004396): A reduced desire to eat. Evidence: TAS. Frequency: Frequent (HP:0040282). (ORPHA:97282)
- Erythema (HP:0010783): Redness of the skin, caused by hyperemia of the capillaries in the lower layers of the skin. Evidence: TAS. Frequency: Frequent (HP:0040282). (ORPHA:97282)
- Chronic fatigue (HP:0012432): Subjective feeling of tiredness characterized by a lack of energy and motivation that persists for six months or longer. Evidence: TAS. Frequency: Frequent (HP:0040282). (ORPHA:97282)
- Intermittent jaundice (HP:0001046): Jaundice that is sometimes present, sometimes not. Evidence: TAS. Frequency: Occasional (HP:0040283). (ORPHA:97282)
- Intrahepatic cholestasis (HP:0001406): Impairment of bile flow due to obstruction in the small bile ducts within the liver. Evidence: TAS. Frequency: Occasional (HP:0040283). (ORPHA:97282)
- Abnormal abdomen morphology (HP:0001438): A structural abnormality of the abdomen ('belly'), that is, the part of the body between the pelvis and the thorax. Evidence: TAS. Frequency: Occasional (HP:0040283). (ORPHA:97282)
- Ascites (HP:0001541): Accumulation of fluid in the peritoneal cavity (between the layers of the peritoneum that lines the abdomen). Evidence: TAS. Frequency: Occasional (HP:0040283). (ORPHA:97282)
- Extrahepatic cholestasis (HP:0012334): Impairment of bile flow due to obstruction in large bile ducts outside the liver. Evidence: TAS. Frequency: Occasional (HP:0040283). (ORPHA:97282)
- Abnormal gastrointestinal motility (HP:0030895): An anomaly of the muscular contractions that propel food though the gastrointestinal tract. Evidence: TAS. Frequency: Occasional (HP:0040283). (ORPHA:97282)
- Abnormality of the thyroid gland (HP:0000820): An abnormality of the thyroid gland. Evidence: TAS. Frequency: Very rare (HP:0040284). (ORPHA:97282)
- Increased circulating gonadotropin level (HP:0000837): Overproduction of gonadotropins (FSH, LH) by the anterior pituitary gland. Evidence: TAS. Frequency: Very rare (HP:0040284). (ORPHA:97282)
- Elevated circulating growth hormone concentration (HP:0000845): Acromegaly is a condition resulting from overproduction of growth hormone by the pituitary gland in persons with closed epiphyses, and consists chiefly in the enlargement of the distal parts of the body. The circumference of the skull increases, the nose becomes broad, the tongue becomes enlarged, the facial features become coarsened, the mandible grows excessively, and the teeth become separated. The fingers and toes grow chiefly in thickness. Evidence: TAS. Frequency: Very rare (HP:0040284). (ORPHA:97282)
- Increased circulating prolactin concentration (HP:0000870): The presence of abnormally increased levels of prolactin in the blood. Prolactin is a peptide hormone produced by the anterior pituitary gland that plays a role in breast development and lactation during pregnancy. Evidence: TAS. Frequency: Very rare (HP:0040284). (ORPHA:97282)
- Subcutaneous lipoma (HP:0001031): The presence of subcutaneous lipoma. Evidence: TAS. Frequency: Very rare (HP:0040284). (ORPHA:97282)
- Respiratory insufficiency due to muscle weakness (HP:0002747). Evidence: TAS. Frequency: Very rare (HP:0040284). (ORPHA:97282)
- Pituitary adenoma (HP:0002893): A benign epithelial tumor derived from intrinsic cells of the adenohypophysis (anterior pituitary). Evidence: TAS. Frequency: Very rare (HP:0040284). (ORPHA:97282)
- Neoplasm of the liver (HP:0002896): A tumor (abnormal growth of tissue) of the liver. Evidence: TAS. Frequency: Very rare (HP:0040284). (ORPHA:97282)
- Parathyroid adenoma (HP:0002897): A benign tumor of the parathyroid gland that can cause hyperparathyroidism. Evidence: TAS. Frequency: Very rare (HP:0040284). (ORPHA:97282)
- Ganglioneuroma (HP:0003005): A benign neoplasm that usually arises from the sympathetic trunk in the mediastinum, representing a tumor of the sympathetic nerve fibers arising from neural crest cells. Evidence: TAS. Frequency: Very rare (HP:0040284). (ORPHA:97282)
- Increased circulating cortisol level (HP:0003118): Overproduction of the hormone of cortisol by the adrenal cortex, resulting in a characteristic combination of clinical symptoms termed Cushing syndrome, with truncal obesity, a round, full face, striae atrophicae and acne, muscle weakness, and other features. Evidence: TAS. Frequency: Very rare (HP:0040284). (ORPHA:97282)
- Elevated circulating calcitonin concentration (HP:0003528): Concentration of calcitonin, a 32-amino acid polypeptide hormone that is produced primarily by the parafollicular cells of the thyroid, in the blood circulation above the upper limit of normal. Evidence: TAS. Frequency: Very rare (HP:0040284). (ORPHA:97282)
- Benign gastrointestinal tract tumors (HP:0006719). Evidence: TAS. Frequency: Very rare (HP:0040284). (ORPHA:97282)
- Follicular thyroid carcinoma (HP:0006731): The presence of an follicular adenocarcinoma of the thyroid gland. Evidence: TAS. Frequency: Very rare (HP:0040284). (ORPHA:97282)
- Primary hyperparathyroidism (HP:0008200): A type of hyperparathyroidism caused by a primary abnormality of the parathyroid glands (e.g., adenoma, carcinoma, hyperplasia). Primary hyperparathyroidism is associated with hyercalcemia. Evidence: TAS. Frequency: Very rare (HP:0040284). (ORPHA:97282)
- Adrenocortical adenoma (HP:0008256): Adrenocortical adenomas are benign tumors of the adrenal cortex. Evidence: TAS. Frequency: Very rare (HP:0040284). (ORPHA:97282)
Not associated with this disease:
- Hematochezia (HP:0002573): The passage of fresh (red) blood per anus, usually in or with stools. Most rectal bleeding comes from the colon, rectum, or anus. Evidence: TAS. (ORPHA:97282)